Phenotypes associated with the disease hydroxyprolinemia (OMIM:237000):
- Microscopic hematuria (HP:0002907): Microscopic hematuria detected by dipstick or microscopic examination of the urine. Evidence: IEA. (OMIM:237000)
- Hydroxyprolinemia (HP:0003260): The concentration of hydroxyproline in the blood circulation is above the upper limit of normal. Evidence: IEA. (OMIM:237000)
- Autosomal recessive inheritance (HP:0000007): A mode of inheritance that is observed for traits related to a gene encoded on one of the autosomes (i.e., the human chromosomes 1-22) in which a trait manifests in individuals with two pathogenic alleles, either homozygotes (two copies of the same mutant allele) or compound heterozygotes (whereby each copy of a gene has a distinct mutant allele). Evidence: IEA. (OMIM:237000)
- Intellectual disability (HP:0001249): The term intellectual disability or intellectual developmental disorder is used to describe significantly sub-average intellectual and adaptive functioning based on clinical assessment and as measured by individually administered, appropriately normed, standardized and validated tests of intellectual functioning and adaptive behavior, with onset during the developmental period from infancy through adolescence. Evidence: IEA. (OMIM:237000)